- Trismus (HP:0000211, a Human Phenotype Ontology term): Limitation in the ability to open the mouth. Evidence: TAS. Frequency: Very frequent (HP:0040281, a Human Phenotype Ontology term). (ORPHA:3299)
- Dysphagia (HP:0002015, a Human Phenotype Ontology term): Difficulty in swallowing. Evidence: TAS. Frequency: Very frequent (HP:0040281, a Human Phenotype Ontology term). (ORPHA:3299)
- Opisthotonus (HP:0002179, a Human Phenotype Ontology term): Opisthotonus is defined as a dramatic abnormal posture due to spastic contraction of the extensor muscles of the neck, trunk, and lower extremities that produces a severe backward arching from neck to heel. In most cases, the trunk is elevated off the ground by a few inches. It is usually sudden in onset and can be sustained or repetitive. It can be considered a variant of decerebrate posturing involving a hyperextension of the neck, back, and limbs. Evidence: TAS. Frequency: Very frequent (HP:0040281, a Human Phenotype Ontology term). (ORPHA:3299)
- Muscle stiffness (HP:0003552, a Human Phenotype Ontology term): A condition in which muscles cannot be moved quickly without accompanying pain or spasm. Evidence: TAS. Frequency: Very frequent (HP:0040281, a Human Phenotype Ontology term). (ORPHA:3299)
- Risus sardonicus (HP:0040212, a Human Phenotype Ontology term): Fixed sarcastic grimace and anxious expression. Caused by spasms of the masseter and other facial muscles. Evidence: TAS. Frequency: Very frequent (HP:0040281, a Human Phenotype Ontology term). (ORPHA:3299)
- Hypertonia (HP:0001276, a Human Phenotype Ontology term): A condition in which there is increased muscle tone so that arms or legs, for example, are stiff and difficult to move. Evidence: TAS. Frequency: Frequent (HP:0040282, a Human Phenotype Ontology term). (ORPHA:3299)
- Tachycardia (HP:0001649, a Human Phenotype Ontology term): A rapid heartrate that exceeds the range of the normal resting heartrate for age. Evidence: TAS. Frequency: Frequent (HP:0040282, a Human Phenotype Ontology term). (ORPHA:3299)
- Fever (HP:0001945, a Human Phenotype Ontology term): Body temperature elevated above the normal range. Evidence: TAS. Frequency: Frequent (HP:0040282, a Human Phenotype Ontology term). (ORPHA:3299)
- Rigidity (HP:0002063, a Human Phenotype Ontology term): Continuous involuntary sustained muscle contraction. When an affected muscle is passively stretched, the degree of resistance remains constant regardless of the rate at which the muscle is stretched. This feature helps to distinguish rigidity from muscle spasticity. Evidence: TAS. Frequency: Frequent (HP:0040282, a Human Phenotype Ontology term). (ORPHA:3299)
- Humoral immunodeficiency (HP:0005363, a Human Phenotype Ontology term): A general term referring to a defect in immunity resulting from impaired antibody production. Evidence: TAS. Frequency: Frequent (HP:0040282, a Human Phenotype Ontology term). (ORPHA:3299)
- Localized skin lesion (HP:0011355, a Human Phenotype Ontology term): A lesion of the skin that is located in a specific region rather than being generalized. Evidence: TAS. Frequency: Frequent (HP:0040282, a Human Phenotype Ontology term). (ORPHA:3299)
- Intermittent painful muscle spasms (HP:0011964, a Human Phenotype Ontology term): History of repeated intermittent involuntary muscle contractions that were painful. Evidence: TAS. Frequency: Frequent (HP:0040282, a Human Phenotype Ontology term). (ORPHA:3299)
- Stiff neck (HP:0025258, a Human Phenotype Ontology term): A sensation of tightness in the neck when attempting to move it, especially after a period of inactivity. Neck stiffness often involves soreness and difficulty moving the neck, especially when trying to turn the head to the side. Evidence: TAS. Frequency: Frequent (HP:0040282, a Human Phenotype Ontology term). (ORPHA:3299)
- Hypertension (HP:0000822, a Human Phenotype Ontology term): The presence of chronic increased pressure in the systemic arterial system. Evidence: TAS. Frequency: Occasional (HP:0040283, a Human Phenotype Ontology term). (ORPHA:3299)
- Coma (HP:0001259, a Human Phenotype Ontology term): The complete absence of wakefulness and consciousness, which is evident through a lack of response to any form of external stimuli. Evidence: TAS. Frequency: Occasional (HP:0040283, a Human Phenotype Ontology term). (ORPHA:3299)
- Tremor (HP:0001337, a Human Phenotype Ontology term): An unintentional, oscillating to-and-fro muscle movement about a joint axis. Evidence: TAS. Frequency: Occasional (HP:0040283, a Human Phenotype Ontology term). (ORPHA:3299)
- Bradycardia (HP:0001662, a Human Phenotype Ontology term): A slower than normal heart rate (in adults, slower than 60 beats per minute). Evidence: TAS. Frequency: Occasional (HP:0040283, a Human Phenotype Ontology term). (ORPHA:3299)
- Abdominal pain (HP:0002027, a Human Phenotype Ontology term): An unpleasant sensation characterized by physical discomfort (such as pricking, throbbing, or aching) and perceived to originate in the abdomen. Evidence: TAS. Frequency: Occasional (HP:0040283, a Human Phenotype Ontology term). (ORPHA:3299)
- Respiratory distress (HP:0002098, a Human Phenotype Ontology term): Respiratory distress is objectively observable as the physical or emotional consequences from the experience of dyspnea. The physical presentation of respiratory distress is generally referred to as labored breathing, while the sensation of respiratory distress is called shortness of breath or dyspnea. Evidence: TAS. Frequency: Occasional (HP:0040283, a Human Phenotype Ontology term). (ORPHA:3299)
- Spasticity of pharyngeal muscles (HP:0002501, a Human Phenotype Ontology term). Evidence: TAS. Frequency: Occasional (HP:0040283, a Human Phenotype Ontology term). (ORPHA:3299)
- Bowel incontinence (HP:0002607, a Human Phenotype Ontology term): Involuntary fecal soiling in adults and children who have usually already been toilet trained. Evidence: TAS. Frequency: Occasional (HP:0040283, a Human Phenotype Ontology term). (ORPHA:3299)
- Tachypnea (HP:0002789, a Human Phenotype Ontology term): Very rapid breathing. Evidence: TAS. Frequency: Occasional (HP:0040283, a Human Phenotype Ontology term). (ORPHA:3299)
- Elevated circulating creatine kinase activity (HP:0003236, a Human Phenotype Ontology term): The activity of creatine kinase in the blood circulation is above the upper limit of normal. Evidence: TAS. Frequency: Occasional (HP:0040283, a Human Phenotype Ontology term). (ORPHA:3299)
- Elevated urinary norepinephrine level (HP:0003345, a Human Phenotype Ontology term): The concentration of noradrenaline in the urine, normalized for urine concentration, is above the upper limit of normal. Evidence: TAS. Frequency: Occasional (HP:0040283, a Human Phenotype Ontology term). (ORPHA:3299)
- Elevated urinary epinephrine level (HP:0003639, a Human Phenotype Ontology term): The concentration of epinephrine in the urine, normalized for urine concentration, is above the upper limit of normal. Evidence: TAS. Frequency: Occasional (HP:0040283, a Human Phenotype Ontology term). (ORPHA:3299)
- Autonomic bladder dysfunction (HP:0005341, a Human Phenotype Ontology term): Abnormal bladder function (increased urge or frequency of urination or urge incontinence) resulting from abnormal functioning of the autonomic nervous system. Evidence: TAS. Frequency: Occasional (HP:0040283, a Human Phenotype Ontology term). (ORPHA:3299)
- Cranial nerve paralysis (HP:0006824, a Human Phenotype Ontology term). Evidence: TAS. Frequency: Occasional (HP:0040283, a Human Phenotype Ontology term). (ORPHA:3299)
- Abnormal autonomic nervous system physiology (HP:0012332, a Human Phenotype Ontology term): A functional abnormality of the autonomic nervous system. Evidence: TAS. Frequency: Occasional (HP:0040283, a Human Phenotype Ontology term). (ORPHA:3299)
- Rigors (HP:0025145, a Human Phenotype Ontology term): Severe chills with violent shivering. A rigor is an episode of shaking or exaggerated shivering which can occur with a high fever. Evidence: TAS. Frequency: Occasional (HP:0040283, a Human Phenotype Ontology term). (ORPHA:3299)
- Laryngospasm (HP:0025425, a Human Phenotype Ontology term): A spasm (involuntary contraction) of the vocal cords that can make it difficult to speak or breathe. Evidence: TAS. Frequency: Occasional (HP:0040283, a Human Phenotype Ontology term). (ORPHA:3299)
These phenotypes are associated with the disease Tetanus (ORPHA:3299, an Orphanet rare-disease identifier).